- Macular degeneration (HP:0000608): A nonspecific term denoting degeneration of the retinal pigment epithelium and/or retinal photoreceptor cells of the macula lutea. Evidence: TAS. Onset: Late onset (HP:0003584). (OMIM:611953)
- Polygenic inheritance (HP:0010982): A mode of inheritance that depends on a mixture of major and minor genetic determinants possibly together with environmental factors. Diseases inherited in this manner are termed complex diseases. Evidence: IEA. (OMIM:611953)
These phenotypes are associated with the disease age related macular degeneration 11 (OMIM:611953).